Phenotypes associated with the disease Multiple myeloma (ORPHA:29073):
- Osteopenia (HP:0000938): Osteopenia is a term to define bone density that is not normal but also not as low as osteoporosis. By definition from the World Health Organization osteopenia is defined by bone densitometry as a T score -1 to -2.5. Evidence: TAS. Frequency: Very frequent (HP:0040281). (ORPHA:29073)
- Pathologic fracture (HP:0002756): A pathologic fracture occurs when a bone breaks in an area that is weakened secondarily to another disease process such as tumor, infection, and certain inherited bone disorders. A pathologic fracture can occur without a degree of trauma required to cause fracture in healthy bone. Evidence: TAS. Frequency: Very frequent (HP:0040281). (ORPHA:29073)
- Nephrotic syndrome (HP:0000100): Nephrotic syndrome is a collection of findings resulting from glomerular dysfunction with an increase in glomerular capillary wall permeability associated with pronounced proteinuria. Nephrotic syndrome refers to the constellation of clinical findings that result from severe renal loss of protein, with Proteinuria and hypoalbuminemia, edema, and hyperlipidemia. Evidence: TAS. Frequency: Frequent (HP:0040282). (ORPHA:29073)
- Nephropathy (HP:0000112): A nonspecific term referring to disease or damage of the kidneys. Evidence: TAS. Frequency: Frequent (HP:0040282). (ORPHA:29073)
- Pallor (HP:0000980): Abnormally pale skin. Evidence: TAS. Frequency: Frequent (HP:0040282). (ORPHA:29073)
- Anemia (HP:0001903): A reduction in erythrocytes volume or hemoglobin concentration. Evidence: TAS. Frequency: Frequent (HP:0040282). (ORPHA:29073)
- Acute kidney injury (HP:0001919): Sudden loss of renal function, as manifested by decreased urine production, and a rise in serum creatinine or blood urea nitrogen concentration (azotemia). Evidence: TAS. Frequency: Frequent (HP:0040282). (ORPHA:29073)
- Hyperproteinemia (HP:0002152): An increased concentration of proteins in the blood. Evidence: TAS. Frequency: Frequent (HP:0040282). (ORPHA:29073)
- Bone pain (HP:0002653): An unpleasant sensation characterized by physical discomfort (such as pricking, throbbing, or aching) localized to bone. Evidence: TAS. Frequency: Frequent (HP:0040282). (ORPHA:29073)
- Osteolysis (HP:0002797): Osteolysis refers to the destruction of bone through bone resorption with removal or loss of calcium. Evidence: TAS. Frequency: Frequent (HP:0040282). (ORPHA:29073)
- Increased circulating IgG concentration (HP:0003237): An abnormally increased level of immunoglobulin G in blood. Evidence: TAS. Frequency: Frequent (HP:0040282). (ORPHA:29073)
- Elevated circulating creatinine concentration (HP:0003259): An increased amount of creatinine in the blood. Evidence: TAS. Frequency: Frequent (HP:0040282). (ORPHA:29073)
- Generalized muscle weakness (HP:0003324): Generalized weakness or decreased strength of the muscles, affecting both distal and proximal musculature. Evidence: TAS. Frequency: Frequent (HP:0040282). (ORPHA:29073)
- Decreased circulating immunoglobulin concentration (HP:0004313): An abnormally decreased level of immunoglobulin in blood. Evidence: TAS. Frequency: Frequent (HP:0040282). (ORPHA:29073)
- Fatigue (HP:0012378): A subjective feeling of tiredness characterized by a lack of energy and motivation. Evidence: TAS. Frequency: Frequent (HP:0040282). (ORPHA:29073)
- Abnormality of the bladder (HP:0000014): An abnormality of the urinary bladder. Evidence: TAS. Frequency: Occasional (HP:0040283). (ORPHA:29073)
- Tall stature (HP:0000098): A height above that which is expected according to age and gender norms. Evidence: TAS. Frequency: Occasional (HP:0040283). (ORPHA:29073)
- Weight loss (HP:0001824): Reduction of total body weight. Evidence: TAS. Frequency: Occasional (HP:0040283). (ORPHA:29073)
- Spinal cord compression (HP:0002176): External mechanical compression of the spinal cord. Evidence: TAS. Frequency: Occasional (HP:0040283). (ORPHA:29073)
- Kyphosis (HP:0002808): Exaggerated anterior convexity of the thoracic vertebral column. Evidence: TAS. Frequency: Occasional (HP:0040283). (ORPHA:29073)
- Vertebral compression fracture (HP:0002953). Evidence: TAS. Frequency: Occasional (HP:0040283). (ORPHA:29073)
- Hypercalcemia (HP:0003072): The concentration of calcium in the blood circulation is above the upper limit of normal. Evidence: TAS. Frequency: Occasional (HP:0040283). (ORPHA:29073)
- Increased circulating IgA concentration (HP:0003261): An abnormally increased level of immunoglobulin A in blood. Evidence: TAS. Frequency: Occasional (HP:0040283). (ORPHA:29073)
- Paresthesia (HP:0003401): Abnormal sensations such as tingling, pricking, or numbness of the skin with no apparent physical cause. Evidence: TAS. Frequency: Occasional (HP:0040283). (ORPHA:29073)
- Abnormal vitamin B12 concentration (HP:0004341): The concentration of vitamin B12 (or one of its metabolites) in the blood circulation is outside the limits of normal. Evidence: TAS. Frequency: Occasional (HP:0040283). (ORPHA:29073)
- Peripheral neuropathy (HP:0009830): Peripheral neuropathy is a general term for any disorder of the peripheral nervous system. The main clinical features used to classify peripheral neuropathy are distribution, type (mainly demyelinating versus mainly axonal), duration, and course. Evidence: TAS. Frequency: Occasional (HP:0040283). (ORPHA:29073)
- Constrictive median neuropathy (HP:0012185): Injury to the median nerve caused by its entrapment at the wrist as it traverses through the carpal tunnel. Clinically, constrictive median neuropathy is characterized by pain, paresthesia, and weakness in the median nerve distribution of the hand. Evidence: TAS. Frequency: Occasional (HP:0040283). (ORPHA:29073)
- Functional abnormality of the gastrointestinal tract (HP:0012719): Abnormal functionality of the gastrointestinal tract. Evidence: TAS. Frequency: Occasional (HP:0040283). (ORPHA:29073)
- Splenomegaly (HP:0001744): Abnormal increased size of the spleen. Evidence: TAS. Frequency: Very rare (HP:0040284). (ORPHA:29073)
- Pleural effusion (HP:0002202): The presence of an excessive amount of fluid in the pleural cavity. Evidence: TAS. Frequency: Very rare (HP:0040284). (ORPHA:29073)
- Lymphadenopathy (HP:0002716): Enlargement (swelling) of a lymph node. Evidence: TAS. Frequency: Very rare (HP:0040284). (ORPHA:29073)